Phenotypes associated with the disease ATTRV30M amyloidosis (ORPHA:85447):
- Nephropathy (HP:0000112): A nonspecific term referring to disease or damage of the kidneys. Evidence: TAS. Frequency: Very frequent (HP:0040281). (ORPHA:85447)
- Polyneuropathy (HP:0001271): A generalized disorder of peripheral nerves. Evidence: TAS. Frequency: Very frequent (HP:0040281). (ORPHA:85447)
- Impotence (HP:0000802): Inability to develop or maintain an erection of the penis. Evidence: TAS. Frequency: Frequent (HP:0040282). (ORPHA:85447)
- Cardiomyopathy (HP:0001638): A myocardial disorder in which the heart muscle is structurally and functionally abnormal, in the absence of coronary artery disease, hypertension, valvular disease and congenital heart disease sufficient to cause the observed myocardial abnormality. Evidence: TAS. Frequency: Frequent (HP:0040282). (ORPHA:85447)
- Cardiomegaly (HP:0001640): Increased size of the heart, clinically defined as an increased transverse diameter of the cardiac silhouette that is greater than or equal to 50% of the transverse diameter of the chest (increased cardiothoracic ratio) on a posterior-anterior projection of a chest radiograph or a computed tomography. Evidence: TAS. Frequency: Frequent (HP:0040282). (ORPHA:85447)
- Atrioventricular block (HP:0001678): Delayed or lack of conduction of atrial depolarizations through the atrioventricular node to the ventricles. Evidence: TAS. Frequency: Frequent (HP:0040282). (ORPHA:85447)
- Weight loss (HP:0001824): Reduction of total body weight. Evidence: TAS. Frequency: Frequent (HP:0040282). (ORPHA:85447)
- Diarrhea (HP:0002014): Abnormally increased frequency (usually defined as three or more) loose or watery bowel movements a day. Evidence: TAS. Frequency: Frequent (HP:0040282). (ORPHA:85447)
- Constipation (HP:0002019): Infrequent or difficult evacuation of feces. Evidence: TAS. Frequency: Frequent (HP:0040282). (ORPHA:85447)
- Arrhythmia (HP:0011675): Any cardiac rhythm other than the normal sinus rhythm. Such a rhythm may be either of sinus or ectopic origin and either regular or irregular. An arrhythmia may be due to a disturbance in impulse formation or conduction or both. Evidence: TAS. Frequency: Frequent (HP:0040282). (ORPHA:85447)
- Constrictive median neuropathy (HP:0012185): Injury to the median nerve caused by its entrapment at the wrist as it traverses through the carpal tunnel. Clinically, constrictive median neuropathy is characterized by pain, paresthesia, and weakness in the median nerve distribution of the hand. Evidence: TAS. Frequency: Frequent (HP:0040282). (ORPHA:85447)
- Abnormal renal physiology (HP:0012211): An abnormal functionality of the kidney. Evidence: TAS. Frequency: Frequent (HP:0040282). (ORPHA:85447)
- Abnormal autonomic nervous system physiology (HP:0012332): A functional abnormality of the autonomic nervous system. Evidence: TAS. Frequency: Frequent (HP:0040282). (ORPHA:85447)
- Vitreous floaters (HP:0100832): Deposits of various size, shape, consistency, refractive index, and motility within the eye's vitreous humor, which is normally transparent. Evidence: TAS. Frequency: Frequent (HP:0040282). (ORPHA:85447)